- Vomiting (HP:0002013): Forceful ejection of the contents of the stomach through the mouth by means of a series of involuntary spasmic contractions. Evidence: IEA. (OMIM:607498)
- Migraine with aura (HP:0002077): A type of migraine in which there is an aura characterized by focal neurological phenomena that usually proceed, but may accompany or occur in the absence of, the headache. The symptoms of an aura may include fully reversible visual, sensory, and speech symptoms but not motor weakness. Visual symptoms may include flickering lights, spots and lines and/or loss of vision and/or unilateral sensory symptoms such as paresthesias or numbness. At least one of the symptoms of an aura develops gradually over 5 or more minutes and/or different symptoms occur in succession. Evidence: IEA. (OMIM:607498)
- Photophobia (HP:0000613): Excessive sensitivity to light with the sensation of discomfort or pain in the eyes due to exposure to bright light. Evidence: IEA. (OMIM:607498)
- Migraine without aura (HP:0002083): Repeated headache attacks lasting 4-72 h fulfilling at least two of the following criteria: 1) unilateral location, 2) pulsating quality, 3) moderate or severe pain intensity, and 4) aggravation by or causing avoidance of routine physical activity such as climbing stairs. Headache attacks are commonly accompanied by nausea, vomiting, photophobia, or phonophobia. Evidence: IEA. (OMIM:607498)
- Phonophobia (HP:0002183): An abnormally heightened sensitivity to loud sounds. Evidence: IEA. (OMIM:607498)
- Nausea (HP:0002018): A sensation of unease in the stomach together with an urge to vomit. Evidence: IEA. (OMIM:607498)
- Autosomal dominant inheritance (HP:0000006): A mode of inheritance that is observed for traits related to a gene encoded on one of the autosomes (i.e., the human chromosomes 1-22) in which a trait manifests in heterozygotes. In the context of medical genetics, an autosomal dominant disorder is caused when a single copy of the mutant allele is present. Males and females are affected equally, and can both transmit the disorder with a risk of 50% for each child of inheriting the mutant allele. Evidence: IEA. (OMIM:607498)
These phenotypes are associated with the disease migraine with or without aura, susceptibility to, 3 (OMIM:607498).